- Congenital onset (HP:0003577): A phenotypic abnormality that is present at birth. Evidence: TAS. (OMIM:608957)
- Absence of CD8+ T cells (HP:0005422): Lack of detectible CD8-positive T cells. Evidence: TAS. (OMIM:608957)
- Bronchiectasis (HP:0002110): Persistent abnormal dilatation of the bronchi owing to localized and irreversible destruction and widening of the large airways. Evidence: TAS. (OMIM:608957)
- Recurrent bacterial infections (HP:0002718): Increased susceptibility to bacterial infections as manifested by recurrent episodes of bacterial infection. Evidence: TAS. (OMIM:608957)
- Autosomal recessive inheritance (HP:0000007): A mode of inheritance that is observed for traits related to a gene encoded on one of the autosomes (i.e., the human chromosomes 1-22) in which a trait manifests in individuals with two pathogenic alleles, either homozygotes (two copies of the same mutant allele) or compound heterozygotes (whereby each copy of a gene has a distinct mutant allele). Evidence: TAS. (OMIM:608957)
- Recurrent viral infections (HP:0004429): Increased susceptibility to viral infections as manifested by recurrent episodes of viral infection. Evidence: TAS. (OMIM:608957)
- Recurrent respiratory infections (HP:0002205): An increased susceptibility to respiratory infections as manifested by a history of recurrent respiratory infections. Evidence: TAS. (OMIM:608957)
These phenotypes are associated with the disease susceptibility to respiratory infections associated with CD8alpha chain mutation (OMIM:608957).